- Narrow chest (HP:0000774): Reduced width of the chest from side to side, associated with a reduced distance from the sternal notch to the tip of the shoulder. Evidence: TAS. Frequency: Occasional (HP:0040283). (ORPHA:157973)
- Hypotonia (HP:0001252): Hypotonia is an abnormally low muscle tone (the amount of tension or resistance to movement in a muscle). Even when relaxed, muscles have a continuous and passive partial contraction which provides some resistance to passive stretching. Hypotonia thus manifests as diminished resistance to passive stretching. Hypotonia is not the same as muscle weakness, although the two conditions can co-exist. Evidence: TAS. Frequency: Frequent (HP:0040282). (ORPHA:157973)
- Global developmental delay (HP:0001263): A delay in the achievement of motor or mental milestones in the domains of development of a child, including motor skills, speech and language, cognitive skills, and social and emotional skills. This term should only be used to describe children younger than five years of age. Evidence: TAS. Frequency: Frequent (HP:0040282). (ORPHA:157973)
- Gait disturbance (HP:0001288): The term gait disturbance can refer to any disruption of the ability to walk. Evidence: TAS. Frequency: Frequent (HP:0040282). (ORPHA:157973)
- Flexion contracture (HP:0001371): A flexion contracture is a bent (flexed) joint that cannot be straightened actively or passively. It is thus a chronic loss of joint motion due to structural changes in muscle, tendons, ligaments, or skin that prevents normal movement of joints. Evidence: TAS. Frequency: Frequent (HP:0040282). (ORPHA:157973)
- Limitation of joint mobility (HP:0001376): A reduction in the freedom of movement of one or more joints. Evidence: TAS. Frequency: Frequent (HP:0040282). (ORPHA:157973)
- Death in infancy (HP:0001522): Death within the first 24 months of life. Evidence: TAS. Frequency: Occasional (HP:0040283). (ORPHA:157973)
- Decreased fetal movement (HP:0001558): An abnormal reduction in quantity or strength of fetal movements. Evidence: TAS. Frequency: Occasional (HP:0040283). (ORPHA:157973)
- Congestive heart failure (HP:0001635): The presence of an abnormality of cardiac function that is responsible for the failure of the heart to pump blood at a rate that is commensurate with the needs of the tissues or a state in which abnormally elevated filling pressures are required for the heart to do so. Heart failure is frequently related to a defect in myocardial contraction. Evidence: TAS. Frequency: Occasional (HP:0040283). (ORPHA:157973)
- Talipes (HP:0001883): A deformity of foot and ankle that has different subtypes that are talipes equinovarus, talipes equinovalgus, talipes calcaneovarus and talipes calcaneovalgus. Evidence: TAS. Frequency: Occasional (HP:0040283). (ORPHA:157973)
- Respiratory insufficiency (HP:0002093). Evidence: TAS. Frequency: Frequent (HP:0040282). (ORPHA:157973)
- Poor head control (HP:0002421): Difficulty to maintain correct position of the head while standing or sitting. Infant head lag is observed when the head seems to flop around or lags posteriorly behind the trunk. Several articles have maintained that head lag should be absent by age 3 to 4 months. Evidence: TAS. Frequency: Very frequent (HP:0040281). (ORPHA:157973)
- Myopathy (HP:0003198): A disorder of muscle unrelated to impairment of innervation or neuromuscular junction. Evidence: TAS. Frequency: Frequent (HP:0040282). (ORPHA:157973)
- Skeletal muscle atrophy (HP:0003202): The presence of skeletal muscular atrophy (which is also known as amyotrophy). Evidence: TAS. Frequency: Frequent (HP:0040282). (ORPHA:157973)
- Spinal rigidity (HP:0003306): Reduced ability to move the vertebral column with a resulting limitation of neck and trunk flexion. Evidence: TAS. Frequency: Frequent (HP:0040282). (ORPHA:157973)
- Hyperlordosis (HP:0003307): Abnormally increased curvature (anterior concavity) of the lumbar or cervical spine. Evidence: TAS. Frequency: Frequent (HP:0040282). (ORPHA:157973)
- Axial muscle weakness (HP:0003327): Reduced strength of the axial musculature (i.e., of the muscles of the head and neck, spine, and ribs). Evidence: TAS. Frequency: Very frequent (HP:0040281). (ORPHA:157973)
- EMG abnormality (HP:0003457): Abnormal results of investigations using electromyography (EMG). Evidence: TAS. Frequency: Frequent (HP:0040282). (ORPHA:157973)
- Cachexia (HP:0004326): Severe weight loss, wasting of muscle, loss of appetite, and general debility related to a chronic disease. Evidence: TAS. Frequency: Occasional (HP:0040283). (ORPHA:157973)
- Arrhythmia (HP:0011675): Any cardiac rhythm other than the normal sinus rhythm. Such a rhythm may be either of sinus or ectopic origin and either regular or irregular. An arrhythmia may be due to a disturbance in impulse formation or conduction or both. Evidence: TAS. Frequency: Occasional (HP:0040283). (ORPHA:157973)
- Feeding difficulties (HP:0011968): Impaired ability to eat related to problems gathering food and getting ready to suck, chew, or swallow it. Evidence: TAS. Frequency: Frequent (HP:0040282). (ORPHA:157973)
- Joint hypermobility (HP:0001382): The capability that a joint (or a group of joints) has to move, passively and/or actively, beyond normal limits along physiological axes. Evidence: TAS. Frequency: Occasional (HP:0040283). (ORPHA:157973)
These phenotypes are associated with the disease Congenital muscular dystrophy due to LMNA mutation (ORPHA:157973).